Phenotypes associated with the disease neurodevelopmental disorder with speech delay and variable ocular anomalies (OMIM:619989):
- Wide mouth (HP:0000154): Distance between the oral commissures more than 2 SD above the mean. Alternatively, an apparently increased width of the oral aperture (subjective). Evidence: PCS. (PMID:35196516)
- Scaphocephaly (HP:0030799): Scaphocephaly is a subtype of dolichocephaly where the anterior and posterior aspects of the cranial vault are pointed (boat-shaped). Scaphocephaly is caused by a precocious fusion of sagittal suture without other associated synostosis. Evidence: PCS. (PMID:35196516)
- Epicanthus (HP:0000286): A fold of skin starting above the medial aspect of the upper eyelid and arching downward to cover, pass in front of and lateral to the medial canthus. Evidence: PCS. (PMID:35196516)
- Microcephaly (HP:0000252): Head circumference below 2 standard deviations below the mean for age and gender. Evidence: PCS. Frequency: 4/10. (PMID:35196516)
- Downslanted palpebral fissures (HP:0000494): The palpebral fissure inclination is more than two standard deviations below the mean. Evidence: PCS. (PMID:35196516)
- Delayed speech and language development (HP:0000750): A degree of language development that is significantly below the norm for a child of a specified age. Evidence: PCS. Frequency: 10/10. (PMID:35196516)
- Hearing impairment (HP:0000365): A decreased magnitude of the sensory perception of sound. Evidence: PCS. Frequency: 6/8. (PMID:35196516)
- Short stature (HP:0004322): A height below that which is expected according to age and gender norms. Although there is no universally accepted definition of short stature, many refer to "short stature" as height more than 2 standard deviations below the mean for age and gender (or below the 3rd percentile for age and gender dependent norms). Evidence: PCS. Frequency: 3/10. (PMID:35196516)
- Febrile seizure (within the age range of 3 months to 6 years) (HP:0002373): A febrile seizure is any type of seizure (most often a generalized tonic-clonic seizure) occurring with fever (at least 38 degrees Celsius) but in the absence of central nervous system infection, severe metabolic disturbance or other alternative precipitant in children between the ages of 3 months and 6 years. Evidence: PCS. Frequency: 6/11. (PMID:35196516)
- Short columella (HP:0002000): Reduced distance from the anterior border of the naris to the subnasale. Evidence: PCS. (PMID:35196516)
- Global developmental delay (HP:0001263): A delay in the achievement of motor or mental milestones in the domains of development of a child, including motor skills, speech and language, cognitive skills, and social and emotional skills. This term should only be used to describe children younger than five years of age. Evidence: PCS. Frequency: 12/12. (PMID:35196516)
- Agenesis of corpus callosum (HP:0001274): Absence of the corpus callosum as a result of the failure of the corpus callosum to develop, which can be the result of a failure in any one of the multiple steps of callosal development including cellular proliferation and migration, axonal growth or glial patterning at the midline. Evidence: PCS. Frequency: 1/7. (PMID:35196516)
- Infantile onset (HP:0003593): Onset of signs or symptoms of disease between 28 days to one year of life. Evidence: PCS. (PMID:35196516)
- Sparse eyebrow (HP:0045075): Decreased density/number of eyebrow hairs. Evidence: PCS. (PMID:35196516)
- Sparse hair (HP:0008070): Reduced density of hairs. Evidence: PCS. (PMID:35196516)
- Smooth philtrum (HP:0000319): Flat skin surface, with no ridge formation in the central region of the upper lip between the nasal base and upper vermilion border. Evidence: PCS. (PMID:35196516)
- Ptosis (HP:0000508): The upper eyelid margin is positioned 3 mm or more lower than usual and covers the superior portion of the iris (objective); or, the upper lid margin obscures at least part of the pupil (subjective). Evidence: PCS. (PMID:35196516)
- Hypertelorism (HP:0000316): Interpupillary distance more than 2 SD above the mean (alternatively, the appearance of an increased interpupillary distance or widely spaced eyes). Evidence: PCS. (PMID:35196516)
- Autosomal recessive inheritance (HP:0000007): A mode of inheritance that is observed for traits related to a gene encoded on one of the autosomes (i.e., the human chromosomes 1-22) in which a trait manifests in individuals with two pathogenic alleles, either homozygotes (two copies of the same mutant allele) or compound heterozygotes (whereby each copy of a gene has a distinct mutant allele). Evidence: PCS. (PMID:35196516)
- Thin upper lip vermilion (HP:0000219): Height of the vermilion of the upper lip in the midline more than 2 SD below the mean. Alternatively, an apparently reduced height of the vermilion of the upper lip in the frontal view (subjective). Evidence: PCS. (PMID:35196516)
- Frontal bossing (HP:0002007): Bilateral bulging of the lateral frontal bone prominences with relative sparing of the midline. Evidence: PCS. (PMID:35196516)
- Intellectual disability (HP:0001249): The term intellectual disability or intellectual developmental disorder is used to describe significantly sub-average intellectual and adaptive functioning based on clinical assessment and as measured by individually administered, appropriately normed, standardized and validated tests of intellectual functioning and adaptive behavior, with onset during the developmental period from infancy through adolescence. Evidence: PCS. Frequency: 12/12. (PMID:35196516)
- Mandibular prognathia (HP:0000303): Abnormal prominence of the chin related to increased length of the mandible. Evidence: PCS. (PMID:35196516)
- Low-set ears (HP:0000369): Upper insertion of the ear to the scalp below an imaginary horizontal line drawn between the inner canthi of the eye and extending posteriorly to the ear. Evidence: PCS. (PMID:35196516)